Phenotypes associated with the disease Dysmorphism-cleft palate-loose skin syndrome (ORPHA:1779):
- Tall stature (HP:0000098): A height above that which is expected according to age and gender norms. Evidence: TAS. Frequency: Very frequent (HP:0040281). (ORPHA:1779)
- Cleft palate (HP:0000175): Cleft palate is a developmental defect of the palate resulting from a failure of fusion of the palatine processes and manifesting as a separation of the roof of the mouth (soft and hard palate). Evidence: TAS. Frequency: Very frequent (HP:0040281). (ORPHA:1779)
- Trigonocephaly (HP:0000243): Wedge-shaped, or triangular head, with the apex of the triangle at the midline of the forehead and the base of the triangle at the occiput. Evidence: TAS. Frequency: Very frequent (HP:0040281). (ORPHA:1779)
- Narrow face (HP:0000275): Bizygomatic (upper face) and bigonial (lower face) width are both more than 2 standard deviations below the mean (objective); or, an apparent reduction in the width of the upper and lower face (subjective). Evidence: TAS. Frequency: Very frequent (HP:0040281). (ORPHA:1779)
- Long face (HP:0000276): Facial height (length) is more than 2 standard deviations above the mean (objective); or, an apparent increase in the height (length) of the face (subjective). Evidence: TAS. Frequency: Very frequent (HP:0040281). (ORPHA:1779)
- Epicanthus (HP:0000286): A fold of skin starting above the medial aspect of the upper eyelid and arching downward to cover, pass in front of and lateral to the medial canthus. Evidence: TAS. Frequency: Very frequent (HP:0040281). (ORPHA:1779)
- Micrognathia (HP:0000347): Developmental hypoplasia of the mandible. Evidence: TAS. Frequency: Very frequent (HP:0040281). (ORPHA:1779)
- Thickened nuchal skin fold (HP:0000474): A thickening of the skin thickness in the posterior aspect of the fetal neck. A nuchal fold (NF) measurement is obtained in a transverse section of the fetal head at the level of the cavum septum pellucidum and thalami, angled posteriorly to include the cerebellum. The measurement is taken from the outer edge of the occiput bone to the outer skin limit directly in the midline. An NF measurement greater than 5 mm at 14 to 17+6 weeks of gestation, or 6 mm at 18 to 28 weeks has been associated with a markedly increased risk for Down syndrome. Evidence: TAS. Frequency: Very frequent (HP:0040281). (ORPHA:1779)
- Intellectual disability (HP:0001249): The term intellectual disability or intellectual developmental disorder is used to describe significantly sub-average intellectual and adaptive functioning based on clinical assessment and as measured by individually administered, appropriately normed, standardized and validated tests of intellectual functioning and adaptive behavior, with onset during the developmental period from infancy through adolescence. Evidence: TAS. Frequency: Very frequent (HP:0040281). (ORPHA:1779)
- Hypotonia (HP:0001252): Hypotonia is an abnormally low muscle tone (the amount of tension or resistance to movement in a muscle). Even when relaxed, muscles have a continuous and passive partial contraction which provides some resistance to passive stretching. Hypotonia thus manifests as diminished resistance to passive stretching. Hypotonia is not the same as muscle weakness, although the two conditions can co-exist. Evidence: TAS. Frequency: Very frequent (HP:0040281). (ORPHA:1779)
- Hyperreflexia (HP:0001347): Hyperreflexia is the presence of hyperactive stretch reflexes of the muscles. Evidence: TAS. Frequency: Very frequent (HP:0040281). (ORPHA:1779)
- Redundant skin (HP:0001582): Loose and sagging skin often associated with loss of skin elasticity. Evidence: TAS. Frequency: Very frequent (HP:0040281). (ORPHA:1779)